- Cataract (HP:0000518): A cataract is an opacity or clouding that develops in the crystalline lens of the eye or in its capsule. Evidence: TAS. Frequency: Frequent (HP:0040282). (ORPHA:369847)
- Intellectual disability (HP:0001249): The term intellectual disability or intellectual developmental disorder is used to describe significantly sub-average intellectual and adaptive functioning based on clinical assessment and as measured by individually administered, appropriately normed, standardized and validated tests of intellectual functioning and adaptive behavior, with onset during the developmental period from infancy through adolescence. Evidence: TAS. Frequency: Frequent (HP:0040282). (ORPHA:369847)
- Global developmental delay (HP:0001263): A delay in the achievement of motor or mental milestones in the domains of development of a child, including motor skills, speech and language, cognitive skills, and social and emotional skills. This term should only be used to describe children younger than five years of age. Evidence: TAS. Frequency: Frequent (HP:0040282). (ORPHA:369847)
- Gait disturbance (HP:0001288): The term gait disturbance can refer to any disruption of the ability to walk. Evidence: TAS. Frequency: Frequent (HP:0040282). (ORPHA:369847)
- Chorea (HP:0002072): Chorea (Greek for 'dance') refers to widespread arrhythmic involuntary movements of a forcible, jerky and restless fashion. It is a random-appearing sequence of one or more discrete involuntary movements or movement fragments. Movements appear random because of variability in timing, duration or location. Each movement may have a distinct start and end. However, movements may be strung together and thus may appear to flow randomly from one muscle group to another. Chorea can involve the trunk, neck, face, tongue, and extremities. Evidence: TAS. Frequency: Frequent (HP:0040282). (ORPHA:369847)
- Truncal ataxia (HP:0002078): Truncal ataxia is a sign of ataxia characterized by instability of the trunk. It usually occurs during sitting. Evidence: TAS. Frequency: Frequent (HP:0040282). (ORPHA:369847)
- Hyperkinetic movements (HP:0002487): Motor hyperactivity with excessive movement of muscles of the body as a whole. Evidence: TAS. Frequency: Frequent (HP:0040282). (ORPHA:369847)
- Scoliosis (HP:0002650): The presence of an abnormal lateral curvature of the spine. Evidence: TAS. Frequency: Frequent (HP:0040282). (ORPHA:369847)
- Myopathy (HP:0003198): A disorder of muscle unrelated to impairment of innervation or neuromuscular junction. Evidence: TAS. Frequency: Frequent (HP:0040282). (ORPHA:369847)
- Myalgia (HP:0003326): Pain in muscle. Evidence: TAS. Frequency: Frequent (HP:0040282). (ORPHA:369847)
- Limb-girdle muscular dystrophy (HP:0006785): Muscular dystrophy affecting the muscles of the limb girdle (the hips and shoulders). Evidence: TAS. Frequency: Frequent (HP:0040282). (ORPHA:369847)
- Exercise-induced muscle fatigue (HP:0009020): An abnormally increased tendency towards muscle fatigue induced by physical exercise. Evidence: TAS. Frequency: Frequent (HP:0040282). (ORPHA:369847)
- Progressive proximal muscle weakness (HP:0009073): Lack of strength of the proximal muscles that becomes progressively more severe. Evidence: TAS. Frequency: Frequent (HP:0040282). (ORPHA:369847)
- Strabismus (HP:0000486): A misalignment of the eyes so that the visual axes deviate from bifoveal fixation. The classification of strabismus may be based on a number of features including the relative position of the eyes, whether the deviation is latent or manifest, intermittent or constant, concomitant or otherwise and according to the age of onset and the relevance of any associated refractive error. Evidence: TAS. Frequency: Occasional (HP:0040283). (ORPHA:369847)
- Myopia (HP:0000545): An abnormality of refraction characterized by the ability to see objects nearby clearly, while objects in the distance appear blurry. Evidence: TAS. Frequency: Occasional (HP:0040283). (ORPHA:369847)
- Seizure (HP:0001250): A seizure is an intermittent abnormality of nervous system physiology characterized by a transient occurrence of signs and/or symptoms due to abnormal excessive or synchronous neuronal activity in the brain. Evidence: TAS. Frequency: Occasional (HP:0040283). (ORPHA:369847)
- Cerebral atrophy (HP:0002059): Atrophy (wasting, decrease in size of cells or tissue) affecting the cerebrum. Evidence: TAS. Frequency: Occasional (HP:0040283). (ORPHA:369847)
- Restrictive ventilatory defect (HP:0002091): A functional defect characterized by reduced total lung capacity (TLC) not associated with abnormalities of expiratory airflow or airway resistance. Spirometrically, a restrictive defect is defined as FEV1 (forced expiratory volume in 1 second) and FVC (forced vital capacity) less than 80 per cent. Restrictive lung disease may be caused by alterations in lung parenchyma or because of a disease of the pleura, chest wall, or neuromuscular apparatus. Evidence: TAS. Frequency: Occasional (HP:0040283). (ORPHA:369847)
- Right ventricular dilatation (HP:0005133): Enlargement of the chamber of the right ventricle, which can be defined echocardiographically as a right ventricular to left ventricular ratio greater than 1:1. Evidence: TAS. Frequency: Occasional (HP:0040283). (ORPHA:369847)
- Floppy infant (HP:0008947): Floppiness/hypotonia is defined as reduced resistance to passive movement of joints. Physical examination of floppy/hypotonic infants shows head lag, lack of shoulder and elbow muscle contraction on traction response, inability to tighten the shoulder girdle muscles (or slipping through) when held under the axillae, scarf sign (when the arm is pulled to the opposite side, the arm wraps around the neck with the elbow crossing midline), hyperdorsiflexion of the feet, easy apposition of the thumb against the forearm, feet touching the cheek with ease and without discomfort, frog leg position, and inverted U sign on ventral suspension (head, arms, and legs hanging down without elbow or knee flexion and the trunk rounded in a dome shape). Evidence: TAS. Frequency: Occasional (HP:0040283). (ORPHA:369847)
These phenotypes are associated with the disease Intellectual disability-hyperkinetic movement-truncal ataxia syndrome (ORPHA:369847).